Phenotypes associated with the disease cardiomyopathy associated with myopathy and sudden death (OMIM:212130):
- Myopathy (HP:0003198): A disorder of muscle unrelated to impairment of innervation or neuromuscular junction. Evidence: IEA. (OMIM:212130)
- Asymmetric septal hypertrophy (HP:0001670): Hypertrophic cardiomyopathy with an asymmetrical pattern of hypertrophy, with a predilection for the interventricular septum and myocyte disarray. Evidence: IEA. (OMIM:212130)
- Autosomal recessive inheritance (HP:0000007): A mode of inheritance that is observed for traits related to a gene encoded on one of the autosomes (i.e., the human chromosomes 1-22) in which a trait manifests in individuals with two pathogenic alleles, either homozygotes (two copies of the same mutant allele) or compound heterozygotes (whereby each copy of a gene has a distinct mutant allele). Evidence: IEA. (OMIM:212130)